- Narrow forehead (HP:0000341): Width of the forehead or distance between the frontotemporales is more than two standard deviations below the mean (objective); or apparently narrow intertemporal region (subjective). Evidence: PCS. Frequency: 2/3. (PMID:33442026)
- Cavum septum pellucidum (HP:0002389): If the two laminae of the septum pellucidum are not fused then a fluid-filled space or cavum is present. The cavum septum pellucidum is present at birth but usually obliterates by the age of 3 to 6 months. It is up to 1cm in width and the walls are parallel. It is an enclosed space and is not part of the ventricular system or connected with the subarachnoid space. Evidence: PCS. Frequency: 1/3. (PMID:33442026)
- Congenital onset (HP:0003577): A phenotypic abnormality that is present at birth. Evidence: PCS. Frequency: 3/3. (PMID:33442026)
- Hearing impairment (HP:0000365): A decreased magnitude of the sensory perception of sound. Evidence: PCS. Frequency: 2/3. (PMID:33442026)
- Short stature (HP:0004322): A height below that which is expected according to age and gender norms. Although there is no universally accepted definition of short stature, many refer to "short stature" as height more than 2 standard deviations below the mean for age and gender (or below the 3rd percentile for age and gender dependent norms). Evidence: PCS. Frequency: 2/3. (PMID:33442026)
- Double inlet left ventricle (HP:0011555): The condition in which both atria are joined to the left ventricle each by its own atrioventricular valve. Usually there is a hypoplastic right ventricle, which may be on the opposite side of the heart as usual. Evidence: PCS. Frequency: 1/3. (PMID:33442026)
- Overhanging nasal tip (HP:0011833): Positioning of the nasal tip inferior to the nasal base. Evidence: PCS. Frequency: 2/3. (PMID:33442026)
- Enlarged cisterna magna (HP:0002280): Increase in size of the cisterna magna, one of three principal openings in the subarachnoid space between the arachnoid and pia mater, located between the cerebellum and the dorsal surface of the medulla oblongata. Evidence: PCS. Frequency: 1/3. (PMID:33442026)
- Polydactyly (HP:0010442): A congenital anomaly characterized by the presence of supernumerary fingers or toes. Evidence: PCS. Frequency: 2/3. (PMID:33442026)
- Sparse eyebrow (HP:0045075): Decreased density/number of eyebrow hairs. Evidence: PCS. Frequency: 2/3. (PMID:33442026)
- Sparse hair (HP:0008070): Reduced density of hairs. Evidence: PCS. Frequency: 2/3. (PMID:33442026)
- Failure to thrive (HP:0001508): Failure to thrive (FTT) refers to a child whose physical growth is substantially below the norm. Evidence: PCS. Frequency: 2/3. (PMID:33442026)
- Nystagmus (HP:0000639): Rhythmic, involuntary oscillations of one or both eyes related to abnormality in fixation, conjugate gaze, or vestibular mechanisms. Evidence: PCS. Frequency: 2/3. (PMID:33442026)
- Cataract (HP:0000518): A cataract is an opacity or clouding that develops in the crystalline lens of the eye or in its capsule. Evidence: PCS. Frequency: 1/3. (PMID:33442026)
- Prominent forehead (HP:0011220): Forward prominence of the entire forehead, due to protrusion of the frontal bone. Evidence: PCS. Frequency: 2/3. (PMID:33442026)
- High palate (HP:0000218): Height of the palate more than 2 SD above the mean (objective) or palatal height at the level of the first permanent molar more than twice the height of the teeth (subjective). Evidence: PCS. Frequency: 1/3. (PMID:33442026)
- Patent ductus arteriosus (HP:0001643): In utero, the ductus arteriosus (DA) serves to divert ventricular output away from the lungs and toward the placenta by connecting the main pulmonary artery to the descending aorta. A patent ductus arteriosus (PDA) in the first 3 days of life is a physiologic shunt in healthy term and preterm newborn infants, and normally is substantially closed within about 24 hours after bith and completely closed after about three weeks. Failure of physiologcal closure is referred to a persistent or patent ductus arteriosus (PDA). Depending on the degree of left-to-right shunting, PDA can have clinical consequences. Evidence: PCS. Frequency: 1/3. (PMID:33442026)
- Retrognathia (HP:0000278): An abnormality in which the mandible is mislocalised posteriorly. Evidence: PCS. Frequency: 3/3. (PMID:33442026)
- Cerebellar vermis hypoplasia (HP:0001320): Underdevelopment of the vermis of cerebellum. Evidence: PCS. Frequency: 1/3. (PMID:33442026)
- Microcephaly (HP:0000252): Head circumference below 2 standard deviations below the mean for age and gender. Evidence: PCS. Frequency: 2/3. (PMID:33442026)
- Lateral ventricle dilatation (HP:0006956). Evidence: PCS. Frequency: 1/3. (PMID:33442026)
- Vesicoureteral reflux (HP:0000076): Abnormal (retrograde) movement of urine from the bladder into ureters or kidneys related to inadequacy of the valvular mechanism at the ureterovesicular junction or other causes. Evidence: PCS. Frequency: 1/3. (PMID:33442026)
- Thin vermilion border (HP:0000233): Height of the vermilion of the medial part of the lip more than 2 SD below the mean, or apparently reduced height of the vermilion of the lip in the frontal view. The vermilion is the red part of the lips (and confusingly, the vermilion itself is also often referred to as being equivalent the lips). Evidence: PCS. Frequency: 3/3. (PMID:33442026)
- Hypoplasia of the corpus callosum (HP:0002079): Underdevelopment of the corpus callosum. Evidence: PCS. Frequency: 2/3. (PMID:33442026)
- Dilated fourth ventricle (HP:0002198): An abnormal dilatation of the fourth cerebral ventricle. Evidence: PCS. Frequency: 1/3. (PMID:33442026)
- Narrow palpebral fissure (HP:0045025): Reduction in the vertical distance between the upper and lower eyelids. Evidence: PCS. Frequency: 3/3. (PMID:33442026)
- Severe global developmental delay (HP:0011344): A severe delay in the achievement of motor or mental milestones in the domains of development of a child. Evidence: PCS. Frequency: 3/3. (PMID:33442026)
- Small for gestational age (HP:0001518): Smaller than normal size according to sex and gestational age related norms, defined as a weight below the 10th percentile for the gestational age. Evidence: PCS. Frequency: 1/3. (PMID:33442026)
- Tetralogy of Fallot (HP:0001636): A congenital cardiac malformation comprising pulmonary stenosis, overriding aorta, ventricular septum defect, and right ventricular hypertrophy. The diagnosis of TOF is made if at least three of the four above mentioned features are present. Evidence: PCS. Frequency: 1/3. (PMID:33442026)
- Autosomal recessive inheritance (HP:0000007): A mode of inheritance that is observed for traits related to a gene encoded on one of the autosomes (i.e., the human chromosomes 1-22) in which a trait manifests in individuals with two pathogenic alleles, either homozygotes (two copies of the same mutant allele) or compound heterozygotes (whereby each copy of a gene has a distinct mutant allele). Evidence: PCS. (PMID:33442026)
- Sclerocornea (HP:0000647): A congenital anomaly in which a part or the whole of the cornea acquires the characteristics of sclera, resulting in clouding of the cornea. Evidence: PCS. Frequency: 1/3. (PMID:33442026)
- Optic disc pallor (HP:0000543): A pale yellow discoloration of the optic disc (the area of the optic nerve head in the retina). The optic disc normally has a pinkish hue with a central yellowish depression. Evidence: PCS. Frequency: 1/3. (PMID:33442026)
- Syndactyly (HP:0001159): Webbing or fusion of the fingers or toes, involving soft parts only or including bone structure. Bony fusions are referred to as "bony" syndactyly if the fusion occurs in a radio-ulnar axis. Fusions of bones of the fingers or toes in a proximo-distal axis are referred to as "symphalangism". Evidence: PCS. Frequency: 2/3. (PMID:33442026)
- Atrial septal defect (HP:0001631): Atrial septal defect (ASD) is a congenital abnormality of the interatrial septum that enables blood flow between the left and right atria via the interatrial septum. Evidence: PCS. Frequency: 1/3. (PMID:33442026)
These phenotypes are associated with the disease neurocardiofaciodigital syndrome (OMIM:619869).